Phenotypes associated with the disease Elastosis perforans serpiginosa (ORPHA:79148):
- Abnormality of the neck (HP:0000464): An abnormality of the neck. Evidence: TAS. Frequency: Very frequent (HP:0040281). (ORPHA:79148)
- Hyperkeratotic papule (HP:0045059): A circumscribed, solid elevation of skin with no visible fluid, varying in size from a pinhead to less than 10mm in diameter at the widest point that is composed of localized hyperkeratosis (the latter may be demonstrated histopathologically). Evidence: TAS. Frequency: Very frequent (HP:0040281). (ORPHA:79148)
- Abnormality of the face (HP:0000271): An abnormality of the face. Evidence: TAS. Frequency: Frequent (HP:0040282). (ORPHA:79148)
- Skin-colored papule (HP:0025512): A papule with the same color as the surrounding skin. Evidence: TAS. Frequency: Frequent (HP:0040282). (ORPHA:79148)
- Serpiginous cutaneous lesion (HP:0025527): A skin lesion with a snake- or serpent-like distribution. Evidence: TAS. Frequency: Frequent (HP:0040282). (ORPHA:79148)
- Annular cutaneous lesion (HP:0025528): A lesion of the skin with a ring-like distribution. Evidence: TAS. Frequency: Frequent (HP:0040282). (ORPHA:79148)
- Erythematous papule (HP:0030350): A circumscribed, solid elevation of skin with no visible fluid that is reddish (erythematous) in color. Evidence: TAS. Frequency: Frequent (HP:0040282). (ORPHA:79148)
- Skin plaque (HP:0200035): A plaque is a solid, raised, plateau-like (flat-topped) lesion greater than 1 cm in diameter. Evidence: TAS. Frequency: Frequent (HP:0040282). (ORPHA:79148)
- Cutis laxa (HP:0000973): Wrinkled, redundant, inelastic and sagging skin. Evidence: TAS. Frequency: Occasional (HP:0040283). (ORPHA:79148)
- Crusting erythematous dermatitis (HP:0007473). Evidence: TAS. Frequency: Occasional (HP:0040283). (ORPHA:79148)
- Epidermal acanthosis (HP:0025092): Diffuse hypertrophy or thickening of the stratum spinosum of the epidermis (prickle cell layer of the skin). Evidence: TAS. Frequency: Occasional (HP:0040283). (ORPHA:79148)